- Humeroradial synostosis (HP:0003041): An abnormal osseous union (fusion) between the radius and the humerus. Evidence: IEA. (OMIM:143050)
- Autosomal dominant inheritance (HP:0000006): A mode of inheritance that is observed for traits related to a gene encoded on one of the autosomes (i.e., the human chromosomes 1-22) in which a trait manifests in heterozygotes. In the context of medical genetics, an autosomal dominant disorder is caused when a single copy of the mutant allele is present. Males and females are affected equally, and can both transmit the disorder with a risk of 50% for each child of inheriting the mutant allele. Evidence: IEA. (OMIM:143050)
These phenotypes are associated with the disease humeroradial synostosis (OMIM:143050).